- Epicanthus (HP:0000286): A fold of skin starting above the medial aspect of the upper eyelid and arching downward to cover, pass in front of and lateral to the medial canthus. Evidence: PCS. Frequency: 1/1. (PMID:30624672)
- Macrodontia (HP:0001572): Increased size of the teeth, which can be defined as a mesiodistal tooth diameter (width) more than 2 SD above mean for age. Alternatively, an apparently increased maximum width of the tooth. Evidence: PCS. (PMID:31207318)
- Pleural effusion (HP:0002202): The presence of an excessive amount of fluid in the pleural cavity. Evidence: PCS. Frequency: 1/1. (PMID:30624672)
- Inability to walk (HP:0002540): Incapability to ambulate. Evidence: PCS. Frequency: 2/2. (PMID:31207318)
- Strabismus (HP:0000486): A misalignment of the eyes so that the visual axes deviate from bifoveal fixation. The classification of strabismus may be based on a number of features including the relative position of the eyes, whether the deviation is latent or manifest, intermittent or constant, concomitant or otherwise and according to the age of onset and the relevance of any associated refractive error. Evidence: PCS. Frequency: 3/3. (PMID:30624672;PMID:31207318)
- Decreased liver function (HP:0001410): Reduced ability of the liver to perform its functions. Evidence: PCS. Frequency: 1/1. (PMID:30624672)
- Anteverted nares (HP:0000463): Anteriorly-facing nostrils viewed with the head in the Frankfurt horizontal and the eyes of the observer level with the eyes of the subject. This gives the appearance of an upturned nose (upturned nasal tip). Evidence: PCS. Frequency: 3/3. (PMID:30624672;PMID:31207318)
- Gait ataxia (HP:0002066): A type of ataxia characterized by the impairment of the ability to coordinate the movements required for normal walking. Gait ataxia is characteirzed by a wide-based staggering gait with a tendency to fall. Evidence: PCS. (PMID:31207318)
- Low posterior hairline (HP:0002162): Hair on the neck extends more inferiorly than usual. Evidence: PCS. Frequency: 1/1. (PMID:30624672)
- Volvulus (HP:0002580): Abnormal twisting of a portion of intestine around itself or around a stalk of mesentery tissue. Evidence: PCS. Frequency: 1/1. (PMID:30624672)
- Generalized hypotonia (HP:0001290): Generalized muscular hypotonia (abnormally low muscle tone). Evidence: PCS. Frequency: 1/1. (PMID:30624672)
- Enlarged cisterna magna (HP:0002280): Increase in size of the cisterna magna, one of three principal openings in the subarachnoid space between the arachnoid and pia mater, located between the cerebellum and the dorsal surface of the medulla oblongata. Evidence: PCS. Frequency: 1/2. (PMID:31207318)
- Hypoplasia of the pons (HP:0012110): Underdevelopment of the pons. Evidence: PCS. Frequency: 1/1. (PMID:30624672)
- Failure to thrive (HP:0001508): Failure to thrive (FTT) refers to a child whose physical growth is substantially below the norm. Evidence: PCS. Frequency: 1/1. (PMID:30624672)
- Cerebral visual impairment (HP:0100704): A form of loss of vision caused by damage to the visual cortex rather than a defect in the eye. Evidence: PCS. Frequency: 1/1. (PMID:30624672)
- Hypertelorism (HP:0000316): Interpupillary distance more than 2 SD above the mean (alternatively, the appearance of an increased interpupillary distance or widely spaced eyes). Evidence: PCS. (PMID:31207318)
- Single transverse palmar crease (HP:0000954): The distal and proximal transverse palmar creases are merged into a single transverse palmar crease. Evidence: PCS. Frequency: 1/1. (PMID:30624672)
- Dandy-Walker malformation (HP:0001305): A congenital brain malformation typically characterized by incomplete formation of the cerebellar vermis, dilation of the fourth ventricle, and enlargement of the posterior fossa. In layman's terms, Dandy Walker malformation is a cyst in the cerebellum (typically symmetrical) that is involved with the fourth ventricle. This may interfere with the ability to drain cerebrospinal fluid from the brain, resulting in hydrocephalus. Dandy Walker cysts are formed during early embryonic development, while the brain forms. The cyst in the cerebellum typically has several blood vessels running through it connecting to the brain, thereby prohibiting surgical removal. Evidence: PCS. Frequency: 1/2. (PMID:31207318)
- Thin upper lip vermilion (HP:0000219): Height of the vermilion of the upper lip in the midline more than 2 SD below the mean. Alternatively, an apparently reduced height of the vermilion of the upper lip in the frontal view (subjective). Evidence: PCS. Frequency: 1/1. (PMID:30624672)
- High palate (HP:0000218): Height of the palate more than 2 SD above the mean (objective) or palatal height at the level of the first permanent molar more than twice the height of the teeth (subjective). Evidence: PCS. Frequency: 11/11. (PMID:30624672;PMID:31207318)
- Delayed ability to sit (HP:0025336): A failure to achieve the ability to sit at an appropriate developmental stage. Most children sit with support at 6 months of age and sit steadily without support at 9 months of age. Evidence: PCS. Frequency: 1/1. (PMID:30624672)
- Constipation (HP:0002019): Infrequent or difficult evacuation of feces. Evidence: PCS. Frequency: 1/1. (PMID:30624672)
- Thick upper lip vermilion (HP:0000215): Height of the vermilion of the upper lip in the midline more than 2 SD above the mean. Alternatively, an apparently increased height of the vermilion of the upper lip in the frontal view (subjective). Evidence: PCS. (PMID:31207318)
- Hypoplastic hippocampus (HP:0025517): Underdevelopment of the hippocampus. Evidence: PCS. Frequency: 1/1. (PMID:30624672)
- Overfolded helix (HP:0000396): A condition in which the helix is folded over to a greater degree than normal. That is, excessive curling of the helix edge, whereby the free edge is parallel to the plane of the ear. Evidence: PCS. Frequency: 1/1. (PMID:30624672)
- Cerebellar vermis hypoplasia (HP:0001320): Underdevelopment of the vermis of cerebellum. Evidence: PCS. Frequency: 1/1. (PMID:30624672)
- Microcephaly (HP:0000252): Head circumference below 2 standard deviations below the mean for age and gender. Evidence: PCS. Frequency: 11/11. (PMID:30624672;PMID:31207318)
- Lateral ventricle dilatation (HP:0006956). Evidence: PCS. (PMID:31207318)
- Status epilepticus (HP:0002133): Status epilepticus is a type of prolonged seizure resulting either from the failure of the mechanisms responsible for seizure termination or from the initiation of mechanisms which lead to abnormally prolonged seizures (after time point t1). It is a condition that can have long-term consequences (after time point t2), including neuronal death, neuronal injury, and alteration of neuronal networks, depending on the type and duration of seizures. Evidence: PCS. Frequency: 1/1. (PMID:30624672)
- Hypoplasia of the corpus callosum (HP:0002079): Underdevelopment of the corpus callosum. Evidence: PCS. Frequency: 3/3. (PMID:30624672;PMID:31207318)
- Feeding difficulties (HP:0011968): Impaired ability to eat related to problems gathering food and getting ready to suck, chew, or swallow it. Evidence: PCS. Frequency: 1/1. (PMID:30624672)
- Asthma (HP:0002099): Asthma is characterized by increased responsiveness of the tracheobronchial tree to multiple stimuli, leading to narrowing of the air passages with resultant dyspnea, cough, and wheezing. Evidence: PCS. Frequency: 1/1. (PMID:30624672)
- Severe global developmental delay (HP:0011344): A severe delay in the achievement of motor or mental milestones in the domains of development of a child. Evidence: PCS. Frequency: 3/3. (PMID:30624672;PMID:31207318)
- Sleep apnea (HP:0010535): An intermittent cessation of airflow at the mouth and nose during sleep is known as sleep apnea. Apneas that last at least 10 seconds are considered significant, but individuals with sleep apnea may experience apneas lasting from 20 seconds up to 2 or 3 minutes. Patients may have up to 15 events per hour of sleep. Evidence: PCS. Frequency: 1/1. (PMID:30624672)
- Edema (HP:0000969): An abnormal accumulation of fluid beneath the skin, or in one or more cavities of the body. Evidence: PCS. Frequency: 1/1. (PMID:30624672)
- Autosomal recessive inheritance (HP:0000007): A mode of inheritance that is observed for traits related to a gene encoded on one of the autosomes (i.e., the human chromosomes 1-22) in which a trait manifests in individuals with two pathogenic alleles, either homozygotes (two copies of the same mutant allele) or compound heterozygotes (whereby each copy of a gene has a distinct mutant allele). Evidence: PCS. (PMID:31207318)
- Clubbing (HP:0001217): Broadening of the soft tissues (non-edematous swelling of soft tissues) of the digital tips in all dimensions associated with an increased longitudinal and lateral curvature of the nails. Evidence: PCS. Frequency: 1/1. (PMID:30624672)
- Long eyelashes (HP:0000527): Mid upper eyelash length >10 mm or increased length of the eyelashes (subjective). Evidence: PCS. Frequency: 1/1. (PMID:30624672)
- Recurrent respiratory infections (HP:0002205): An increased susceptibility to respiratory infections as manifested by a history of recurrent respiratory infections. Evidence: PCS. Frequency: 1/1. (PMID:30624672)
- Short philtrum (HP:0000322): Distance between nasal base and midline upper lip vermilion border more than 2 SD below the mean. Alternatively, an apparently decreased distance between nasal base and midline upper lip vermilion border. Evidence: PCS. Frequency: 1/2. (PMID:31207318)
These phenotypes are associated with the disease pontocerebellar hypoplasia, type 13 (OMIM:618606).